- Young adult onset (HP:0011462): Onset of disease at the age of between 16 and 40 years. Evidence: TAS. (OMIM:206550)
- Autosomal recessive inheritance (HP:0000007): A mode of inheritance that is observed for traits related to a gene encoded on one of the autosomes (i.e., the human chromosomes 1-22) in which a trait manifests in individuals with two pathogenic alleles, either homozygotes (two copies of the same mutant allele) or compound heterozygotes (whereby each copy of a gene has a distinct mutant allele). Evidence: TAS. (OMIM:206550)
- Cutaneous angiolipomas (HP:0006773). Evidence: TAS. (OMIM:206550)
These phenotypes are associated with the disease familial angiolipomatosis (OMIM:206550).